- Multiple lipomas (HP:0001012): The presence of multiple lipomas (a type of benign tissue made of fatty tissue). Evidence: TAS. (OMIM:151900)
- Autosomal dominant inheritance (HP:0000006): A mode of inheritance that is observed for traits related to a gene encoded on one of the autosomes (i.e., the human chromosomes 1-22) in which a trait manifests in heterozygotes. In the context of medical genetics, an autosomal dominant disorder is caused when a single copy of the mutant allele is present. Males and females are affected equally, and can both transmit the disorder with a risk of 50% for each child of inheriting the mutant allele. Evidence: TAS. (OMIM:151900)
These phenotypes are associated with the disease familial multiple lipomatosis (OMIM:151900).